- Microcephaly (HP:0000252): Head circumference below 2 standard deviations below the mean for age and gender. Evidence: PCS. Frequency: 3/3. (PMID:22775483)
- Congenital onset (HP:0003577): A phenotypic abnormality that is present at birth. Evidence: PCS. (PMID:22775483)
- Moderate intellectual disability (HP:0002342): Moderate intellectual disability (ID) is defined as a type of ID characterized by moderately sub-average adaptive functioning and intellectual functioning, with an intelligence quotient (IQ) the range of 35-49. Evidence: PCS. Frequency: 2/2. (PMID:22775483)
- Strabismus (HP:0000486): A misalignment of the eyes so that the visual axes deviate from bifoveal fixation. The classification of strabismus may be based on a number of features including the relative position of the eyes, whether the deviation is latent or manifest, intermittent or constant, concomitant or otherwise and according to the age of onset and the relevance of any associated refractive error. Evidence: PCS. Frequency: 2/2. (PMID:20978018)
- Absent speech (HP:0001344): Complete lack of development of speech and language abilities. Evidence: PCS. Frequency: 1/3. (PMID:22775483)
- Small cerebral cortex (HP:0002472): Reduced size of the cerebral cortex. Evidence: IEA. (OMIM:608393)
- Seizure (HP:0001250): A seizure is an intermittent abnormality of nervous system physiology characterized by a transient occurrence of signs and/or symptoms due to abnormal excessive or synchronous neuronal activity in the brain. Evidence: PCS. Frequency: 2/2. (PMID:20978018)
- Global developmental delay (HP:0001263): A delay in the achievement of motor or mental milestones in the domains of development of a child, including motor skills, speech and language, cognitive skills, and social and emotional skills. This term should only be used to describe children younger than five years of age. Evidence: PCS. Frequency: 2/2. (PMID:20978018)
- Microtia (HP:0008551): Underdevelopment of the external ear. Evidence: PCS. Frequency: 2/2. (PMID:20978018)
- Hypertelorism (HP:0000316): Interpupillary distance more than 2 SD above the mean (alternatively, the appearance of an increased interpupillary distance or widely spaced eyes). Evidence: PCS. Frequency: 2/2. (PMID:20978018)
- Autosomal recessive inheritance (HP:0000007): A mode of inheritance that is observed for traits related to a gene encoded on one of the autosomes (i.e., the human chromosomes 1-22) in which a trait manifests in individuals with two pathogenic alleles, either homozygotes (two copies of the same mutant allele) or compound heterozygotes (whereby each copy of a gene has a distinct mutant allele). Evidence: PCS. (PMID:22775483)
- Bifid nasal tip (HP:0000456): A splitting of the nasal tip. Visually assessable vertical indentation, cleft, or depression of the nasal tip. Evidence: PCS. Frequency: 2/2. (PMID:20978018)
These phenotypes are associated with the disease microcephaly 6, primary, autosomal recessive (OMIM:608393).